Phenotypes associated with the disease Aneurysm-osteoarthritis syndrome (ORPHA:284984):
- Pes planus (HP:0001763): A foot where the longitudinal arch of the foot is in contact with the ground or floor when the individual is standing; or, in a patient lying supine, a foot where the arch is in contact with the surface of a flat board pressed against the sole of the foot by the examiner with a pressure similar to that expected from weight bearing; or, the height of the arch is reduced. Evidence: TAS. Frequency: Very frequent (HP:0040281). (ORPHA:284984)
- Vascular dilatation (HP:0002617): An abnormal increase in the diameter of an artery or vein, either as a diffuse dilatation or as a localized, sac-like outpouching of the vessel wall (aneurysm). Evidence: TAS. Frequency: Very frequent (HP:0040281). (ORPHA:284984)
- Dilatation of the sinus of Valsalva (HP:0011645): Abnormal outpouching or sac-like dilatation of one of the anatomic dilations of the ascending aorta, which occurs just above the aortic valve. Evidence: TAS. Frequency: Very frequent (HP:0040281). (ORPHA:284984)
- Inguinal hernia (HP:0000023): Protrusion of the contents of the abdominal cavity through the inguinal canal. Evidence: TAS. Frequency: Frequent (HP:0040282). (ORPHA:284984)
- Uterine prolapse (HP:0000139): The presence of prolapse of the uterus. Evidence: TAS. Frequency: Frequent (HP:0040282). (ORPHA:284984)
- Bifid uvula (HP:0000193): Uvula separated into two parts most easily seen at the tip. Evidence: TAS. Frequency: Frequent (HP:0040282). (ORPHA:284984)
- High palate (HP:0000218): Height of the palate more than 2 SD above the mean (objective) or palatal height at the level of the first permanent molar more than twice the height of the teeth (subjective). Evidence: TAS. Frequency: Frequent (HP:0040282). (ORPHA:284984)
- Malar flattening (HP:0000272): Underdevelopment of the malar prominence of the jugal bone (zygomatic bone in mammals), appreciated in profile, frontal view, and/or by palpation. Evidence: TAS. Frequency: Frequent (HP:0040282). (ORPHA:284984)
- Long face (HP:0000276): Facial height (length) is more than 2 standard deviations above the mean (objective); or, an apparent increase in the height (length) of the face (subjective). Evidence: TAS. Frequency: Frequent (HP:0040282). (ORPHA:284984)
- Hypertelorism (HP:0000316): Interpupillary distance more than 2 SD above the mean (alternatively, the appearance of an increased interpupillary distance or widely spaced eyes). Evidence: TAS. Frequency: Frequent (HP:0040282). (ORPHA:284984)
- High forehead (HP:0000348): An abnormally increased height of the forehead. Evidence: TAS. Frequency: Frequent (HP:0040282). (ORPHA:284984)
- Dental malocclusion (HP:0000689): Dental malocclusion refers to an abnormality of the occlusion, or alignment, of the teeth and the way the upper and lower teeth fit together, resulting in overcrowding of teeth or in abnormal bite patterns. Evidence: TAS. Frequency: Frequent (HP:0040282). (ORPHA:284984)
- Bruising susceptibility (HP:0000978): An ecchymosis (bruise) refers to the skin discoloration caused by the escape of blood into the tissues from ruptured blood vessels. This term refers to an abnormally increased susceptibility to bruising. The corresponding phenotypic abnormality is generally elicited on medical history as a report of frequent ecchymoses or bruising without adequate trauma. Evidence: TAS. Frequency: Frequent (HP:0040282). (ORPHA:284984)
- Atypical scarring of skin (HP:0000987): Atypically scarred skin . Evidence: TAS. Frequency: Frequent (HP:0040282). (ORPHA:284984)
- Striae distensae (HP:0001065): Thinned, erythematous, depressed bands of atrophic skin. Initially, striae appear as flattened and thinned, pinkish linear regions of the skin. Striae tend to enlarge in length and become reddish or purplish. Later, striae tend to appear as white, depressed bands that are parallel to the lines of skin tension. Striae distensae occur most often in areas that have been subject to distension such as the lower back, buttocks, thighs, breast, abdomen, and shoulders. Evidence: TAS. Frequency: Frequent (HP:0040282). (ORPHA:284984)
- Arachnodactyly (HP:0001166): Abnormally long and slender fingers (spider fingers). Evidence: TAS. Frequency: Frequent (HP:0040282). (ORPHA:284984)
- Umbilical hernia (HP:0001537): Protrusion of abdominal contents through a defect in the abdominal wall musculature around the umbilicus. Skin and subcutaneous tissue overlie the defect. Evidence: TAS. Frequency: Frequent (HP:0040282). (ORPHA:284984)
- Mitral regurgitation (HP:0001653): An abnormality of the mitral valve characterized by insufficiency or incompetence of the mitral valve resulting in retrograde leaking of blood through the mitral valve upon ventricular contraction. Evidence: TAS. Frequency: Frequent (HP:0040282). (ORPHA:284984)
- Aortic regurgitation (HP:0001659): An insufficiency of the aortic valve, leading to regurgitation (backward flow) of blood from the aorta into the left ventricle. Evidence: TAS. Frequency: Frequent (HP:0040282). (ORPHA:284984)
- Migraine (HP:0002076): Migraine is a chronic neurological disorder characterized by episodic attacks of headache and associated symptoms. Evidence: TAS. Frequency: Frequent (HP:0040282). (ORPHA:284984)
- Headache (HP:0002315): Cephalgia, or pain sensed in various parts of the head, not confined to the area of distribution of any nerve. Evidence: TAS. Frequency: Frequent (HP:0040282). (ORPHA:284984)
- Aortic dissection (HP:0002647): Aortic dissection refers to a tear in the intimal layer of the aorta causing a separation between the intima and the medial layers of the aorta. Evidence: TAS. Frequency: Frequent (HP:0040282). (ORPHA:284984)
- Scoliosis (HP:0002650): The presence of an abnormal lateral curvature of the spine. Evidence: TAS. Frequency: Frequent (HP:0040282). (ORPHA:284984)
- Osteoarthritis (HP:0002758): Degeneration (wear and tear) of articular cartilage, i.e., of the joint surface. Joint degeneration may be accompanied by osteophytes (bone overgrowth), narrowing of the joint space, regions of sclerosis at the joint surface, or joint deformity. Evidence: TAS. Frequency: Frequent (HP:0040282). (ORPHA:284984)
- Protrusio acetabuli (HP:0003179): Intrapelvic bulging of the medial acetabular wall. Evidence: TAS. Frequency: Frequent (HP:0040282). (ORPHA:284984)
- Osteoarthritis of the small joints of the hand (HP:0004268). Evidence: TAS. Frequency: Frequent (HP:0040282). (ORPHA:284984)
- Dilatation of the cerebral artery (HP:0004944): The presence of a localized dilatation or ballooning of a cerebral artery. Evidence: TAS. Frequency: Frequent (HP:0040282). (ORPHA:284984)
- Knee osteoarthritis (HP:0005086). Evidence: TAS. Frequency: Frequent (HP:0040282). (ORPHA:284984)
- Arterial tortuosity (HP:0005116): Abnormal tortuous (i.e., twisted) form of arteries. Evidence: TAS. Frequency: Frequent (HP:0040282). (ORPHA:284984)
- Arterial dissection (HP:0005294): A separation (dissection) of the layers of an artery. Evidence: TAS. Frequency: Frequent (HP:0040282). (ORPHA:284984)
- Chronic fatigue (HP:0012432): Subjective feeling of tiredness characterized by a lack of energy and motivation that persists for six months or longer. Evidence: TAS. Frequency: Frequent (HP:0040282). (ORPHA:284984)
- Abnormal bladder morphology (HP:0025487): Any structural anomaly of the bladder. Evidence: TAS. Frequency: Frequent (HP:0040282). (ORPHA:284984)
- Retrognathia (HP:0000278): An abnormality in which the mandible is mislocalised posteriorly. Evidence: TAS. Frequency: Occasional (HP:0040283). (ORPHA:284984)
- Pectus excavatum (HP:0000767): A defect of the chest wall characterized by a depression of the sternum, giving the chest ("pectus") a caved-in ("excavatum") appearance. Evidence: TAS. Frequency: Occasional (HP:0040283). (ORPHA:284984)
- Pectus carinatum (HP:0000768): A deformity of the chest caused by overgrowth of the ribs and characterized by protrusion of the sternum. Evidence: TAS. Frequency: Occasional (HP:0040283). (ORPHA:284984)
- Joint hypermobility (HP:0001382): The capability that a joint (or a group of joints) has to move, passively and/or actively, beyond normal limits along physiological axes. Evidence: TAS. Frequency: Occasional (HP:0040283). (ORPHA:284984)
- Disproportionate tall stature (HP:0001519): A tall and slim body build with increased arm span to height ratio (>1.05) and a reduced upper-to-lower segment ratio (<0.85), i.e., unusually long arms and legs. The extremities as well as the hands and feet are unusually slim. Evidence: TAS. Frequency: Occasional (HP:0040283). (ORPHA:284984)
- Abnormal heart morphology (HP:0001627): Any structural anomaly of the heart. Evidence: TAS. Frequency: Occasional (HP:0040283). (ORPHA:284984)
- Pulmonic stenosis (HP:0001642): A narrowing of the right ventricular outflow tract that can occur at the pulmonary valve (valvular stenosis), below the pulmonary valve (infundibular stenosis), or above the pulmonary valve (supravalvar stenosis). Evidence: TAS. Frequency: Occasional (HP:0040283). (ORPHA:284984)
- Left ventricular hypertrophy (HP:0001712): Enlargement or increased size of the heart left ventricle. Evidence: TAS. Frequency: Occasional (HP:0040283). (ORPHA:284984)
- Spondylolisthesis (HP:0003302): Complete bilateral fractures of the pars interarticularis resulting in the anterior slippage of the vertebra. Evidence: TAS. Frequency: Occasional (HP:0040283). (ORPHA:284984)
- Atrial fibrillation (HP:0005110): An atrial arrhythmia characterized by disorganized atrial activity without discrete P waves on the surface EKG, but instead by an undulating baseline or more sharply circumscribed atrial deflections of varying amplitude an frequency ranging from 350 to 600 per minute. Evidence: TAS. Frequency: Occasional (HP:0040283). (ORPHA:284984)
- Abdominal aortic aneurysm (HP:0005112): An abnormal localized widening (dilatation) of the abdominal aorta. Evidence: TAS. Frequency: Occasional (HP:0040283). (ORPHA:284984)
- Intervertebral disk degeneration (HP:0008419): The presence of degenerative changes of intervertebral disk. Evidence: TAS. Frequency: Occasional (HP:0040283). (ORPHA:284984)
- Osteochondritis dissecans (HP:0010886): A joint disorder caused by blood deprivation in the subchondral bone causing the subchondral bone to die in a process called avascular necrosis. The bone is then reabsorbed by the body, leaving the articular cartilage it supported prone to damage. The result is fragmentation (dissection) of both cartilage and bone, and the free movement of these osteochondral fragments within the joint space, causing pain and further damage. Evidence: TAS. Frequency: Occasional (HP:0040283). (ORPHA:284984)
- Camptodactyly of finger (HP:0100490): The distal interphalangeal joint and/or the proximal interphalangeal joint of the fingers cannot be extended to 180 degrees by either active or passive extension. Evidence: TAS. Frequency: Occasional (HP:0040283). (ORPHA:284984)
- Dural ectasia (HP:0100775): A widening or ballooning of the dural sac surrounding the spinal cord usually at the lumbosacral level. Evidence: TAS. Frequency: Occasional (HP:0040283). (ORPHA:284984)
- Cleft palate (HP:0000175): Cleft palate is a developmental defect of the palate resulting from a failure of fusion of the palatine processes and manifesting as a separation of the roof of the mouth (soft and hard palate). Evidence: TAS. Frequency: Very rare (HP:0040284). (ORPHA:284984)
- Osteoporosis (HP:0000939): Osteoporosis is a systemic skeletal disease characterized by low bone density and microarchitectural deterioration of bone tissue with a consequent increase in bone fragility. According to the WHO criteria, osteoporosis is defined as a BMD that lies 2.5 standard deviations or more below the average value for young healthy adults (a T-score below -2.5 SD). Evidence: TAS. Frequency: Very rare (HP:0040284). (ORPHA:284984)
- Patent ductus arteriosus (HP:0001643): In utero, the ductus arteriosus (DA) serves to divert ventricular output away from the lungs and toward the placenta by connecting the main pulmonary artery to the descending aorta. A patent ductus arteriosus (PDA) in the first 3 days of life is a physiologic shunt in healthy term and preterm newborn infants, and normally is substantially closed within about 24 hours after bith and completely closed after about three weeks. Failure of physiologcal closure is referred to a persistent or patent ductus arteriosus (PDA). Depending on the degree of left-to-right shunting, PDA can have clinical consequences. Evidence: TAS. Frequency: Very rare (HP:0040284). (ORPHA:284984)
Not associated with this disease:
- Craniosynostosis (HP:0001363): Craniosynostosis refers to the premature closure of the cranial sutures. Primary craniosynostosis refers to the closure of one or more sutures due to abnormalities in skull development, and secondary craniosynostosis results from failure of brain growth. Evidence: TAS. (ORPHA:284984)